Phenotypes associated with the disease Urachal sinus (ORPHA:431344):
- Abdominal pain (HP:0002027): An unpleasant sensation characterized by physical discomfort (such as pricking, throbbing, or aching) and perceived to originate in the abdomen. Evidence: TAS. Frequency: Occasional (HP:0040283). (ORPHA:431344)
- Abdominal wall mass (HP:6000171): An abnormal enlargement or swelling localized to the abdominal wall (the skin, fascia, and muscle encases the abdominal cavity and viscera). The word mass is usually used at an early stage of the diagnostic workup before the precise nature of the swelling has been determined. Evidence: TAS. Frequency: Occasional (HP:0040283). (ORPHA:431344)
- Neoplasm (HP:0002664): An organ or organ-system abnormality that consists of uncontrolled autonomous cell-proliferation which can occur in any part of the body as a benign or malignant neoplasm (tumor). Evidence: TAS. Frequency: Very rare (HP:0040284). (ORPHA:431344)
- Bladder fistula (HP:0004321): The presence of a fistula connecting the urinary bladder to another organ or the skin. The fistula can involve the bowel, the vagina, or rarely, the skin. Evidence: TAS. Frequency: Very rare (HP:0040284). (ORPHA:431344)